Phenotypes associated with the disease Cataract-nephropathy-encephalopathy syndrome (ORPHA:1380, an Orphanet rare-disease identifier):
- Renal tubular dysfunction (HP:0000124, a Human Phenotype Ontology term): Abnormal function of the renal tubule. The basic functional unit of the kidney, the nephron, consists of a renal corpuscle attached to a renal tubule, with roughly 0.8 to 1.5 nephrons per adult kidney. The functions of the renal tubule include reabsorption of water, electrolytes, glucose, and amino acids and secretion of substances such as uric acid. Evidence: TAS. Frequency: Very frequent (HP:0040281, a Human Phenotype Ontology term). (ORPHA:1380)
- Cataract (HP:0000518, a Human Phenotype Ontology term): A cataract is an opacity or clouding that develops in the crystalline lens of the eye or in its capsule. Evidence: TAS. Frequency: Very frequent (HP:0040281, a Human Phenotype Ontology term). (ORPHA:1380)
- Nystagmus (HP:0000639, a Human Phenotype Ontology term): Rhythmic, involuntary oscillations of one or both eyes related to abnormality in fixation, conjugate gaze, or vestibular mechanisms. Evidence: TAS. Frequency: Frequent (HP:0040282, a Human Phenotype Ontology term). (ORPHA:1380)
- Intellectual disability (HP:0001249, a Human Phenotype Ontology term): The term intellectual disability or intellectual developmental disorder is used to describe significantly sub-average intellectual and adaptive functioning based on clinical assessment and as measured by individually administered, appropriately normed, standardized and validated tests of intellectual functioning and adaptive behavior, with onset during the developmental period from infancy through adolescence. Evidence: TAS. Frequency: Very frequent (HP:0040281, a Human Phenotype Ontology term). (ORPHA:1380)
- Seizure (HP:0001250, a Human Phenotype Ontology term): A seizure is an intermittent abnormality of nervous system physiology characterized by a transient occurrence of signs and/or symptoms due to abnormal excessive or synchronous neuronal activity in the brain. Evidence: TAS. Frequency: Very frequent (HP:0040281, a Human Phenotype Ontology term). (ORPHA:1380)
- Short stature (HP:0004322, a Human Phenotype Ontology term): A height below that which is expected according to age and gender norms. Although there is no universally accepted definition of short stature, many refer to "short stature" as height more than 2 standard deviations below the mean for age and gender (or below the 3rd percentile for age and gender dependent norms). Evidence: TAS. Frequency: Very frequent (HP:0040281, a Human Phenotype Ontology term). (ORPHA:1380)